Phenotypes associated with the disease Hereditary arginine vasopressin deficiency (ORPHA:30925):
- Irritability (HP:0000737): An emotional state characterized by negative feelings of heightened frustration, annoyance, or feeling upset, often triggered by internal factors (e.g., fatigue, hunger, unfulfilled desires) or external factors (e.g., social or environmental challenges). Irritability may be unpredictable, and is accompanied by a lowered threshold for emotional reactivity and observable features (speech, facial expressions, or psychomotor activity). Evidence: TAS. Frequency: Frequent (HP:0040282). (ORPHA:30925)
- Diabetes insipidus (HP:0000873): A state of excessive water intake and hypotonic (dilute) polyuria. Diabetes insipidus may be due to failure of vasopressin (AVP) release (central or neurogenic diabetes insipidus) or to a failure of the kidney to respond to AVP (nephrogenic diabetes insipidus). Evidence: TAS. Frequency: Very frequent (HP:0040281). (ORPHA:30925)
- Lethargy (HP:0001254): A state of fatigue, either physical or mental slowness and sluggishness, with difficulties in initiating or performing simple tasks. Distinguished from apathy which implies indifference and a lack of desire or interest in the task. A person with lethargy may have the desire, but not the energy to engage in personal or socially relevant tasks. Evidence: TAS. Frequency: Frequent (HP:0040282). (ORPHA:30925)
- Growth delay (HP:0001510): A deficiency or slowing down of growth pre- and postnatally. Evidence: TAS. Frequency: Frequent (HP:0040282). (ORPHA:30925)
- Weight loss (HP:0001824): Reduction of total body weight. Evidence: TAS. Frequency: Frequent (HP:0040282). (ORPHA:30925)
- Fever (HP:0001945): Body temperature elevated above the normal range. Evidence: TAS. Frequency: Frequent (HP:0040282). (ORPHA:30925)
- Polydipsia (HP:0001959): Excessive thirst manifested by excessive fluid intake. Evidence: TAS. Frequency: Very frequent (HP:0040281). (ORPHA:30925)
- Vomiting (HP:0002013): Forceful ejection of the contents of the stomach through the mouth by means of a series of involuntary spasmic contractions. Evidence: TAS. Frequency: Frequent (HP:0040282). (ORPHA:30925)
- Diarrhea (HP:0002014): Abnormally increased frequency (usually defined as three or more) loose or watery bowel movements a day. Evidence: TAS. Frequency: Frequent (HP:0040282). (ORPHA:30925)